Phenotypes associated with the disease muscular dystrophy, congenital, with rapid progression (OMIM:254100):
- Muscular dystrophy (HP:0003560): The term dystrophy means abnormal growth. However, muscular dystrophy is used to describe primary myopathies with a genetic basis and a progressive course characterized by progressive skeletal muscle weakness and wasting, defects in muscle proteins, and histological features of muscle fiber degeneration (necrosis) and regeneration. If possible, it is preferred to use other HPO terms to describe the precise phenotypic abnormalities. Evidence: IEA. (OMIM:254100)
- Autosomal recessive inheritance (HP:0000007): A mode of inheritance that is observed for traits related to a gene encoded on one of the autosomes (i.e., the human chromosomes 1-22) in which a trait manifests in individuals with two pathogenic alleles, either homozygotes (two copies of the same mutant allele) or compound heterozygotes (whereby each copy of a gene has a distinct mutant allele). Evidence: IEA. (OMIM:254100)
- Muscle weakness (HP:0001324): Reduced strength of muscles. Evidence: IEA. (OMIM:254100)
- Rapidly progressive (HP:0003678): Applies to a disease manifestation that quickly increases in scope or severity over the course of time. Evidence: IEA. (OMIM:254100)